- Shortened sleep phase (HP:0033063): A tendency to sleep fewer hours than usual while feeling well-rested. Evidence: PCS. Frequency: 2/2. (PMID:31619542)
- Autosomal dominant inheritance (HP:0000006): A mode of inheritance that is observed for traits related to a gene encoded on one of the autosomes (i.e., the human chromosomes 1-22) in which a trait manifests in heterozygotes. In the context of medical genetics, an autosomal dominant disorder is caused when a single copy of the mutant allele is present. Males and females are affected equally, and can both transmit the disorder with a risk of 50% for each child of inheriting the mutant allele. Evidence: PCS. (PMID:31619542)
These phenotypes are associated with the disease Short sleep, familial natural, 3  (OMIM:621336).